Phenotypes associated with the disease ovarian cancer (OMIM:167000):
- Breast carcinoma (HP:0003002): The presence of a carcinoma of the breast. Evidence: IEA. (OMIM:167000)
- Dysgerminoma (HP:0100621): The presence of a dysgerminoma, i.e., an undifferentiated germ cell tumor of the ovary. Evidence: TAS. (OMIM:167000)
- Typified by somatic mosaicism (HP:0001442): Description of conditions in which affected individuals typically display somatic mosaicism, i.e., genetically distinct populations of somatic cells in a given organism caused by DNA mutations, epigenetic alterations of DNA, chromosomal abnormalities or the spontaneous reversion of inherited mutations. In many conditions typified by somatic mosaicism, constitutive mutation is lethal and cases are exclusively or predominantly mosaic. Evidence: IEA. (OMIM:167000)
- Ovarian papillary adenocarcinoma (HP:0006774): The presence of a papillary adenocarcinoma of the ovary. Evidence: IEA. (OMIM:167000)
- Autosomal dominant inheritance (HP:0000006): A mode of inheritance that is observed for traits related to a gene encoded on one of the autosomes (i.e., the human chromosomes 1-22) in which a trait manifests in heterozygotes. In the context of medical genetics, an autosomal dominant disorder is caused when a single copy of the mutant allele is present. Males and females are affected equally, and can both transmit the disorder with a risk of 50% for each child of inheriting the mutant allele. Evidence: IEA. (OMIM:167000)